- Hyperactivity (HP:0000752): Hyperactivity is a condition characterized by constant and unusually high levels of activity, even in situations where it is deemed inappropriate. Evidence: IEA. (OMIM:143465)
- Attention deficit hyperactivity disorder (HP:0007018): Attention deficit hyperactivity disorder (ADHD) manifests at age 2-3 years or by first grade at the latest. The main symptoms are distractibility, impulsivity, hyperactivity, and often trouble organizing tasks and projects, difficulty going to sleep, and social problems from being aggressive, loud, or impatient. Evidence: TAS. (OMIM:143465)
- Autosomal dominant inheritance (HP:0000006): A mode of inheritance that is observed for traits related to a gene encoded on one of the autosomes (i.e., the human chromosomes 1-22) in which a trait manifests in heterozygotes. In the context of medical genetics, an autosomal dominant disorder is caused when a single copy of the mutant allele is present. Males and females are affected equally, and can both transmit the disorder with a risk of 50% for each child of inheriting the mutant allele. Evidence: IEA. (OMIM:143465)
These phenotypes are associated with the disease hereditary attention deficit-hyperactivity disorder (OMIM:143465).